- Sensorineural hearing impairment (HP:0000407): A type of hearing impairment in one or both ears related to an abnormal functionality of the cochlear nerve. Evidence: PCS. Frequency: 10/10. Onset: Juvenile onset (HP:0003621). (PMID:25816005)
- Autosomal dominant inheritance (HP:0000006): A mode of inheritance that is observed for traits related to a gene encoded on one of the autosomes (i.e., the human chromosomes 1-22) in which a trait manifests in heterozygotes. In the context of medical genetics, an autosomal dominant disorder is caused when a single copy of the mutant allele is present. Males and females are affected equally, and can both transmit the disorder with a risk of 50% for each child of inheriting the mutant allele. Evidence: PCS. (PMID:25816005)
These phenotypes are associated with the disease autosomal dominant nonsyndromic hearing loss 68 (OMIM:616707).